- Narrow mouth (HP:0000160): Distance between the commissures of the mouth more than 2 SD below the mean. Alternatively, an apparently decreased width of the oral aperture (subjective). Evidence: TAS. Frequency: Very frequent (HP:0040281). (ORPHA:1968)
- Malar flattening (HP:0000272): Underdevelopment of the malar prominence of the jugal bone (zygomatic bone in mammals), appreciated in profile, frontal view, and/or by palpation. Evidence: TAS. Frequency: Very frequent (HP:0040281). (ORPHA:1968)
- Long face (HP:0000276): Facial height (length) is more than 2 standard deviations above the mean (objective); or, an apparent increase in the height (length) of the face (subjective). Evidence: TAS. Frequency: Very frequent (HP:0040281). (ORPHA:1968)
- Broad forehead (HP:0000337): Width of the forehead or distance between the frontotemporales is more than two standard deviations above the mean (objective); or apparently increased distance between the two sides of the forehead. Evidence: TAS. Frequency: Very frequent (HP:0040281). (ORPHA:1968)
- Long philtrum (HP:0000343): Distance between nasal base and midline upper lip vermilion border more than 2 SD above the mean. Alternatively, an apparently increased distance between nasal base and midline upper lip vermilion border. Evidence: TAS. Frequency: Very frequent (HP:0040281). (ORPHA:1968)
- Micrognathia (HP:0000347): Developmental hypoplasia of the mandible. Evidence: TAS. Frequency: Very frequent (HP:0040281). (ORPHA:1968)
- High forehead (HP:0000348): An abnormally increased height of the forehead. Evidence: TAS. Frequency: Very frequent (HP:0040281). (ORPHA:1968)
- Macrotia (HP:0000400): Median longitudinal ear length greater than two standard deviations above the mean and median ear width greater than two standard deviations above the mean (objective); or, apparent increase in length and width of the pinna (subjective). Evidence: TAS. Frequency: Very frequent (HP:0040281). (ORPHA:1968)
- Underdeveloped nasal alae (HP:0000430): Thinned, deficient, or excessively arched ala nasi. Evidence: TAS. Frequency: Very frequent (HP:0040281). (ORPHA:1968)
- Wide nasal bridge (HP:0000431): Increased breadth of the nasal bridge (and with it, the nasal root). Evidence: TAS. Frequency: Very frequent (HP:0040281). (ORPHA:1968)
- Telecanthus (HP:0000506): Distance between the inner canthi more than two standard deviations above the mean (objective); or, apparently increased distance between the inner canthi. Evidence: TAS. Frequency: Very frequent (HP:0040281). (ORPHA:1968)
- Blepharophimosis (HP:0000581): A fixed reduction in the vertical distance between the upper and lower eyelids with short palpebral fissures. Evidence: TAS. Frequency: Very frequent (HP:0040281). (ORPHA:1968)
- Hypernasal speech (HP:0001611): A type of speech characterized by the presence of an abnormally increased nasal airflow during speech associated with structural abnormality of the nasal passages. Evidence: TAS. Frequency: Very frequent (HP:0040281). (ORPHA:1968)
- Highly arched eyebrow (HP:0002553): Increased height of the central portion of the eyebrow, forming a crescent, semicircular, or inverted U shape. Evidence: TAS. Frequency: Very frequent (HP:0040281). (ORPHA:1968)
- High, narrow palate (HP:0002705): The presence of a high and narrow palate. Evidence: TAS. Frequency: Very frequent (HP:0040281). (ORPHA:1968)
- Downturned corners of mouth (HP:0002714): A morphological abnormality of the mouth in which the angle of the mouth is downturned. The oral commissures are positioned inferior to the midline labial fissure. Evidence: TAS. Frequency: Very frequent (HP:0040281). (ORPHA:1968)
- Long nose (HP:0003189): Distance from nasion to subnasale more than two standard deviations above the mean, or alternatively, an apparently increased length from the nasal root to the nasal base. Evidence: TAS. Frequency: Very frequent (HP:0040281). (ORPHA:1968)
- Abnormal antihelix morphology (HP:0009738): An abnormality of the antihelix. Evidence: TAS. Frequency: Very frequent (HP:0040281). (ORPHA:1968)
- Abnormal antitragus morphology (HP:0009896): An abnormality of the antitragus, which is a small tubercle opposite to the tragus of the ear. The antitragus and the tragus are separated by the intertragic notch. Evidence: TAS. Frequency: Very frequent (HP:0040281). (ORPHA:1968)
- Aplasia/Hypoplasia of the earlobes (HP:0009906): Absence or underdevelopment of the ear lobes. Evidence: TAS. Frequency: Very frequent (HP:0040281). (ORPHA:1968)
- Abnormal tragus morphology (HP:0009912): An abnormality of the tragus. Evidence: TAS. Frequency: Very frequent (HP:0040281). (ORPHA:1968)
- Hypoplasia of the zygomatic bone (HP:0010669): Underdevelopment of the zygomatic bone. That is, a reduction in size of the zygomatic bone, including the zygomatic process of the temporal bone of the skull, which forms part of the zygomatic arch. Evidence: TAS. Frequency: Very frequent (HP:0040281). (ORPHA:1968)
- Dimple chin (HP:0010751): A persistent midline depression of the skin over the fat pad of the chin. Evidence: TAS. Frequency: Very frequent (HP:0040281). (ORPHA:1968)
- Flat face (HP:0012368): Absence of concavity or convexity of the face when viewed in profile. Evidence: TAS. Frequency: Very frequent (HP:0040281). (ORPHA:1968)
- Sparse eyebrow (HP:0045075): Decreased density/number of eyebrow hairs. Evidence: TAS. Frequency: Very frequent (HP:0040281). (ORPHA:1968)
- Inguinal hernia (HP:0000023): Protrusion of the contents of the abdominal cavity through the inguinal canal. Evidence: TAS. Frequency: Frequent (HP:0040282). (ORPHA:1968)
- Cryptorchidism (HP:0000028): Testis in inguinal canal. That is, absence of one or both testes from the scrotum owing to failure of the testis or testes to descend through the inguinal canal to the scrotum. Evidence: TAS. Frequency: Frequent (HP:0040282). (ORPHA:1968)
- Small scrotum (HP:0000046): Apparently small scrotum for age. Evidence: TAS. Frequency: Frequent (HP:0040282). (ORPHA:1968)
- Scoliosis (HP:0002650): The presence of an abnormal lateral curvature of the spine. Evidence: TAS. Frequency: Frequent (HP:0040282). (ORPHA:1968)
- Abnormal oral mucosa morphology (HP:0011830): Abnormality of the oral mucosa. Evidence: TAS. Frequency: Occasional (HP:0040283). (ORPHA:1968)
- Camptodactyly of finger (HP:0100490): The distal interphalangeal joint and/or the proximal interphalangeal joint of the fingers cannot be extended to 180 degrees by either active or passive extension. Evidence: TAS. Frequency: Occasional (HP:0040283). (ORPHA:1968)
- Posteriorly rotated ears (HP:0000358): A type of abnormal location of the ears in which the position of the ears is characterized by posterior rotation (the superior part of the ears is rotated towards the back of the head, and the inferior part of the ears towards the front). Evidence: TAS. Frequency: Frequent (HP:0040282). (ORPHA:1968)
These phenotypes are associated with the disease Flat face-microstomia-ear anomaly syndrome (ORPHA:1968).